Phenotypes associated with the disease Tetralogy of Fallot (ORPHA:3303):
- Cryptorchidism (HP:0000028): Testis in inguinal canal. That is, absence of one or both testes from the scrotum owing to failure of the testis or testes to descend through the inguinal canal to the scrotum. Evidence: TAS. Frequency: Frequent (HP:0040282). (ORPHA:3303)
- Thin vermilion border (HP:0000233): Height of the vermilion of the medial part of the lip more than 2 SD below the mean, or apparently reduced height of the vermilion of the lip in the frontal view. The vermilion is the red part of the lips (and confusingly, the vermilion itself is also often referred to as being equivalent the lips). Evidence: TAS. Frequency: Frequent (HP:0040282). (ORPHA:3303)
- Dolichocephaly (HP:0000268): An abnormality of skull shape characterized by a increased anterior-posterior diameter, i.e., an increased antero-posterior dimension of the skull. Cephalic index less than 76%. Alternatively, an apparently increased antero-posterior length of the head compared to width. Often due to premature closure of the sagittal suture. Evidence: TAS. Frequency: Frequent (HP:0040282). (ORPHA:3303)
- Broad forehead (HP:0000337): Width of the forehead or distance between the frontotemporales is more than two standard deviations above the mean (objective); or apparently increased distance between the two sides of the forehead. Evidence: TAS. Frequency: Very frequent (HP:0040281). (ORPHA:3303)
- Proptosis (HP:0000520): An eye that is protruding anterior to the plane of the face to a greater extent than is typical. Evidence: TAS. Frequency: Frequent (HP:0040282). (ORPHA:3303)
- Brachydactyly (HP:0001156): Digits that appear disproportionately short compared to the hand/foot. The word brachydactyly is used here to describe a series distinct patterns of shortened digits (brachydactyly types A-E). This is the sense used here. Evidence: TAS. Frequency: Very frequent (HP:0040281). (ORPHA:3303)
- Intrauterine growth retardation (HP:0001511): An abnormal restriction of fetal growth with fetal weight below the tenth percentile for gestational age. Evidence: TAS. Frequency: Very frequent (HP:0040281). (ORPHA:3303)
- Tetralogy of Fallot (HP:0001636): A congenital cardiac malformation comprising pulmonary stenosis, overriding aorta, ventricular septum defect, and right ventricular hypertrophy. The diagnosis of TOF is made if at least three of the four above mentioned features are present. Evidence: TAS. Frequency: Frequent (HP:0040282). (ORPHA:3303)
- Clinodactyly of the 5th finger (HP:0004209): Clinodactyly refers to a bending or curvature of the fifth finger in the radial direction (i.e., towards the 4th finger). Evidence: TAS. Frequency: Very frequent (HP:0040281). (ORPHA:3303)
- Preauricular pit (HP:0004467): Small indentation anterior to the insertion of the ear. Evidence: TAS. Frequency: Frequent (HP:0040282). (ORPHA:3303)
- Abnormal nasal morphology (HP:0005105). Evidence: TAS. Frequency: Very frequent (HP:0040281). (ORPHA:3303)
- Underdeveloped supraorbital ridges (HP:0009891): Flatness of the supraorbital portion of the frontal bones. Evidence: TAS. Frequency: Frequent (HP:0040282). (ORPHA:3303)